Phenotypes associated with the disease Tricuspid atresia (ORPHA:1209):
- Tricuspid atresia (HP:0011662): Failure to develop of the tricuspid valve and thus lack of the normal connection between the right atrium and the right ventricle. Evidence: TAS. Frequency: Obligate (HP:0040280). (ORPHA:1209)
- Cyanosis (HP:0000961): Bluish discoloration of the skin and mucosa due to poor circulation or inadequate oxygenation of arterial or capillary blood. Evidence: TAS. Frequency: Very frequent (HP:0040281). (ORPHA:1209)
- Ventricular septal defect (HP:0001629): A hole between the two bottom chambers (ventricles) of the heart. The defect is centered around the most superior aspect of the ventricular septum. Evidence: TAS. Frequency: Very frequent (HP:0040281). (ORPHA:1209)
- Atrial septal defect (HP:0001631): Atrial septal defect (ASD) is a congenital abnormality of the interatrial septum that enables blood flow between the left and right atria via the interatrial septum. Evidence: TAS. Frequency: Frequent (HP:0040282). (ORPHA:1209)
- Patent foramen ovale (HP:0001655): Failure of the foramen ovale to seal postnatally, leaving a potential conduit between the left and right cardiac atria. Evidence: TAS. Frequency: Frequent (HP:0040282). (ORPHA:1209)
- Transposition of the great arteries (HP:0001669): A complex congenital heart defect in which the aorta arises from the morphologic right ventricle and the pulmonary artery arises from the morphologic left ventricle. Evidence: TAS. Frequency: Frequent (HP:0040282). (ORPHA:1209)
- Hypoplasia of right ventricle (HP:0004762): Underdevelopment or reduced size of the heart right ventricle, often due to a reduced number of cells. Evidence: TAS. Frequency: Frequent (HP:0040282). (ORPHA:1209)
- Persistent left superior vena cava (HP:0005301): A rare congenital vascular anomaly that results when the left superior cardinal vein caudal to the innominate vein fails to regress. Evidence: TAS. Frequency: Frequent (HP:0040282). (ORPHA:1209)
- Coarctation of aorta (HP:0001680): Coarctation of the aorta is a narrowing or constriction of a segment of the aorta. Evidence: TAS. Frequency: Occasional (HP:0040283). (ORPHA:1209)
- Pulmonary artery atresia (HP:0004935): A congenital anomaly with a narrowing or complete absence of the opening between the right ventricle and the pulmonary artery. Evidence: TAS. Frequency: Occasional (HP:0040283). (ORPHA:1209)